- Bilateral tonic-clonic seizure (HP:0002069): A bilateral tonic-clonic seizure is a seizure defined by a tonic (bilateral increased tone, lasting seconds to minutes) and then a clonic (bilateral sustained rhythmic jerking) phase. Evidence: IEA. (OMIM:608217)
- Infantile onset (HP:0003593): Onset of signs or symptoms of disease between 28 days to one year of life. Evidence: IEA. (OMIM:608217)
- Autosomal dominant inheritance (HP:0000006): A mode of inheritance that is observed for traits related to a gene encoded on one of the autosomes (i.e., the human chromosomes 1-22) in which a trait manifests in heterozygotes. In the context of medical genetics, an autosomal dominant disorder is caused when a single copy of the mutant allele is present. Males and females are affected equally, and can both transmit the disorder with a risk of 50% for each child of inheriting the mutant allele. Evidence: IEA. (OMIM:608217)
These phenotypes are associated with the disease seizures, benign familial neonatal, 3 (OMIM:608217).